Phenotypes associated with the disease atrial septal defect 1 (OMIM:108800):
- Aortic valve stenosis (HP:0001650): The presence of a stenosis (narrowing) of the aortic valve. Evidence: PCS. (PMID:9610535)
- Subvalvular aortic stenosis (HP:0001682): A fixed form of obstruction to blood flow across the left-ventricular outflow tract related to stenosis (narrowing) below the level of the aortic valve. Evidence: PCS. (PMID:9610535)
- Secundum atrial septal defect (HP:0001684): A kind of atrial septum defect arising from an enlarged foramen ovale, inadequate growth of the septum secundum, or excessive absorption of the septum primum. Evidence: PCS. (PMID:9610535)
- Persistent left superior vena cava (HP:0005301): A rare congenital vascular anomaly that results when the left superior cardinal vein caudal to the innominate vein fails to regress. Evidence: PCS. (PMID:9610535)
- Ventricular septal defect (HP:0001629): A hole between the two bottom chambers (ventricles) of the heart. The defect is centered around the most superior aspect of the ventricular septum. Evidence: PCS. (PMID:9610535)
- Second degree atrioventricular block (HP:0011706): An intermittent atrioventricular block with failure of some atrial impulses to conduct to the ventricles, i.e., some but not all atrial impulses are conducted through the atrioventricular node and trigger ventricular contraction. Evidence: PCS. (PMID:9610535)
- Bicuspid aortic valve (HP:0001647): The presence of an aortic valve with two instead of the normal three cusps (flaps). Bicuspid aortic valvue is a malformation of a commissure (small space between the attachment of each cusp to the aortic wall) and the adjacent parts of the two corresponding cusps forming a raphe (the fused area of the two underdeveloped cusps turning into a malformed commissure between both cusps; the raphe is a fibrous ridge that extends from the commissure to the free edge of the two underdeveloped, conjoint cusps). Evidence: PCS. (PMID:9610535)
- Tetralogy of Fallot with pulmonary atresia (HP:0012516): An extreme form of tetralogy of Fallot characterized by absence of flow from the right ventricle to the pulmonary arteries. Evidence: PCS. (PMID:9610535)
- Atrial septal defect (HP:0001631): Atrial septal defect (ASD) is a congenital abnormality of the interatrial septum that enables blood flow between the left and right atria via the interatrial septum. Evidence: PCS. (PMID:9610535)
- Atrial septal dilatation (HP:0011995): A bulging of the interatrial septum towards one side. In adults, atrial septal aneurysm can be defined as a protrusion of the aneurysm of >10 mm beyond the plane of the atrial septum as measured by transesophageal echocardiography. Evidence: PCS. (PMID:9610535)
- Autosomal dominant inheritance (HP:0000006): A mode of inheritance that is observed for traits related to a gene encoded on one of the autosomes (i.e., the human chromosomes 1-22) in which a trait manifests in heterozygotes. In the context of medical genetics, an autosomal dominant disorder is caused when a single copy of the mutant allele is present. Males and females are affected equally, and can both transmit the disorder with a risk of 50% for each child of inheriting the mutant allele. Evidence: TAS. (OMIM:108800)